- Hydrocephalus (HP:0000238): Hydrocephalus is an active distension of the ventricular system of the brain resulting from inadequate passage of CSF from its point of production within the cerebral ventricles to its point of absorption into the systemic circulation. Evidence: TAS. Frequency: Very frequent (HP:0040281). (ORPHA:251912)
- Nausea and vomiting (HP:0002017): Nausea is a commonly encountered symptom that has been defined as an unpleasant painless subjective feeling that one will imminently vomit. Vomiting has been defined as the forceful expulsion of the contents of the stomach, duodenum, or jejunum through the oral cavity. While nausea and vomiting are often thought to exist on a temporal continuum, this is not always the case. There are situations when severe nausea may be present without emesis and less frequently, when emesis may be present without preceding nausea. Evidence: TAS. Frequency: Very frequent (HP:0040281). (ORPHA:251912)
- Headache (HP:0002315): Cephalgia, or pain sensed in various parts of the head, not confined to the area of distribution of any nerve. Evidence: TAS. Frequency: Very frequent (HP:0040281). (ORPHA:251912)
- Memory impairment (HP:0002354): An impairment of memory as manifested by a reduced ability to remember things such as dates and names, and increased forgetfulness. Evidence: TAS. Frequency: Very frequent (HP:0040281). (ORPHA:251912)
- Increased intracranial pressure (HP:0002516): An increase of the pressure inside the cranium (skull) and thereby in the brain tissue and cerebrospinal fluid. Evidence: TAS. Frequency: Very frequent (HP:0040281). (ORPHA:251912)
- Abnormal eyelid morphology (HP:0000492): An abnormality of the eyelids. Evidence: TAS. Frequency: Frequent (HP:0040282). (ORPHA:251912)
- Nystagmus (HP:0000639): Rhythmic, involuntary oscillations of one or both eyes related to abnormality in fixation, conjugate gaze, or vestibular mechanisms. Evidence: TAS. Frequency: Frequent (HP:0040282). (ORPHA:251912)
- Episodic ataxia (HP:0002131): Periodic spells of incoordination and imbalance, that is, episodes of ataxia typically lasting from 10 minutes to several hours or days. Evidence: TAS. Frequency: Frequent (HP:0040282). (ORPHA:251912)
- Increased CSF protein concentration (HP:0002922): Increased concentration of protein in the cerebrospinal fluid. Evidence: TAS. Frequency: Frequent (HP:0040282). (ORPHA:251912)
- Altitudinal visual field defect (HP:0030531). Evidence: TAS. Frequency: Frequent (HP:0040282). (ORPHA:251912)
- Cognitive impairment (HP:0100543): Abnormal cognition is characterized by deficits in thinking, reasoning, or remembering. Evidence: TAS. Frequency: Frequent (HP:0040282). (ORPHA:251912)
- Hearing abnormality (HP:0000364): An abnormality of the sensory perception of sound. Evidence: TAS. Frequency: Occasional (HP:0040283). (ORPHA:251912)
- Gait disturbance (HP:0001288): The term gait disturbance can refer to any disruption of the ability to walk. Evidence: TAS. Frequency: Occasional (HP:0040283). (ORPHA:251912)
These phenotypes are associated with the disease Pineocytoma (ORPHA:251912).